Phenotypes associated with the disease spastic paraplegia with associated extrapyramidal signs (OMIM:182800):
- Abnormality of extrapyramidal motor function (HP:0002071): A neurological condition related to lesions of the basal ganglia leading to typical abnormalities including akinesia (inability to initiate changes in activity and perform volitional movements rapidly and easily), muscular rigidity (continuous contraction of muscles with constant resistance to passive movement), chorea (widespread arrhythmic movements of a forcible, rapid, jerky, and restless nature), athetosis (inability to sustain the muscles of the fingers, toes, or other group of muscles in a fixed position), and akathisia (inability to remain motionless). Evidence: IEA. (OMIM:182800)
- Spastic paraplegia (HP:0001258): Complete loss of the ability to move the lower limbs accompanied by spasticity of the lower limbs. Evidence: IEA. (OMIM:182800)
- Autosomal dominant inheritance (HP:0000006): A mode of inheritance that is observed for traits related to a gene encoded on one of the autosomes (i.e., the human chromosomes 1-22) in which a trait manifests in heterozygotes. In the context of medical genetics, an autosomal dominant disorder is caused when a single copy of the mutant allele is present. Males and females are affected equally, and can both transmit the disorder with a risk of 50% for each child of inheriting the mutant allele. Evidence: IEA. (OMIM:182800)